- Bilateral sensorineural hearing impairment (HP:0008619): A form of sensorineural hearing impairment that affects both ears. Evidence: TAS. (OMIM:604717)
- Progressive sensorineural hearing impairment (HP:0000408): A progressive form of sensorineural hearing impairment. Evidence: TAS. (OMIM:604717)
- Young adult onset (HP:0011462): Onset of disease at the age of between 16 and 40 years. Evidence: TAS. (OMIM:604717)
- Autosomal dominant inheritance (HP:0000006): A mode of inheritance that is observed for traits related to a gene encoded on one of the autosomes (i.e., the human chromosomes 1-22) in which a trait manifests in heterozygotes. In the context of medical genetics, an autosomal dominant disorder is caused when a single copy of the mutant allele is present. Males and females are affected equally, and can both transmit the disorder with a risk of 50% for each child of inheriting the mutant allele. Evidence: PCS. (PMID:13680526)
These phenotypes are associated with the disease autosomal dominant nonsyndromic hearing loss 20 (OMIM:604717).